- Reduced factor XI activity (HP:0001929): Decreased activity of coagulation factor XI. Factor XI, also known as plasma thromboplastin antecedent, is a serine proteinase that activates factor IX. Evidence: IEA. (OMIM:134540)
- Reduced factor IX activity (HP:0011858): Decreased activity of coagulation factor IX. Factor IX, which itself is activated by factor Xa or factor VIIa to form factor IXa, activates factor X into factor Xa. Evidence: IEA. (OMIM:134540)
- Autosomal dominant inheritance (HP:0000006): A mode of inheritance that is observed for traits related to a gene encoded on one of the autosomes (i.e., the human chromosomes 1-22) in which a trait manifests in heterozygotes. In the context of medical genetics, an autosomal dominant disorder is caused when a single copy of the mutant allele is present. Males and females are affected equally, and can both transmit the disorder with a risk of 50% for each child of inheriting the mutant allele. Evidence: IEA. (OMIM:134540)
These phenotypes are associated with the disease factor 9 and Factor XI, combined deficiency of (OMIM:134540).